Phenotypes associated with the disease epilepsy, idiopathic generalized, susceptibility to, 3 (OMIM:608762):
- Bilateral tonic-clonic seizure (HP:0002069): A bilateral tonic-clonic seizure is a seizure defined by a tonic (bilateral increased tone, lasting seconds to minutes) and then a clonic (bilateral sustained rhythmic jerking) phase. Evidence: TAS. (OMIM:608762)
- Cutaneous photosensitivity (HP:0000992): An increased sensitivity of the skin to light. Photosensitivity may result in a rash upon exposure to the sun (which is known as photodermatosis). Photosensitivity can be diagnosed by phototests in which light is shone on small areas of skin. Evidence: TAS. (OMIM:608762)
- Seizure (HP:0001250): A seizure is an intermittent abnormality of nervous system physiology characterized by a transient occurrence of signs and/or symptoms due to abnormal excessive or synchronous neuronal activity in the brain. Evidence: IEA. (OMIM:608762)
- Autosomal recessive inheritance (HP:0000007): A mode of inheritance that is observed for traits related to a gene encoded on one of the autosomes (i.e., the human chromosomes 1-22) in which a trait manifests in individuals with two pathogenic alleles, either homozygotes (two copies of the same mutant allele) or compound heterozygotes (whereby each copy of a gene has a distinct mutant allele). Evidence: TAS. (OMIM:608762)